Phenotypes associated with the disease Zollinger-Ellison syndrome (ORPHA:913):
- Zollinger-Ellison syndrome (HP:0002044): A condition in which there is increased production of gastrin by a gastrin-secreting tumor (usually located in the pancreas, duodenum, or abdominal lymph nodes) that stimulates the gastric mucosa to maximal activity, with consequent gastrointestinal mucosal ulceration. Evidence: TAS. Frequency: Obligate (HP:0040280). (ORPHA:913)
- Neuroendocrine neoplasm (HP:0100634): A tumor that originates from a neuroendocrine cell. Evidence: TAS. Frequency: Obligate (HP:0040280). (ORPHA:913)
- Diarrhea (HP:0002014): Abnormally increased frequency (usually defined as three or more) loose or watery bowel movements a day. Evidence: TAS. Frequency: Very frequent (HP:0040281). (ORPHA:913)
- Nausea (HP:0002018): A sensation of unease in the stomach together with an urge to vomit. Evidence: TAS. Frequency: Very frequent (HP:0040281). (ORPHA:913)
- Episodic abdominal pain (HP:0002574): An intermittent form of abdominal pain. Evidence: TAS. Frequency: Very frequent (HP:0040281). (ORPHA:913)
- Duodenal ulcer (HP:0002588): An erosion of the mucous membrane in a portion of the duodenum. Evidence: TAS. Frequency: Very frequent (HP:0040281). (ORPHA:913)
- Peptic ulcer (HP:0004398): The term peptic ulcer refers to acid peptic injury of the digestive tract, resulting in mucosal break reaching the submucosa. Peptic ulcers are usually located in the stomach or proximal duodenum, but they can also be found in the esophagus or Meckel's diverticulum. Infection with Helicobacter pylori and the use of non steroidal antiinflammatory drugs (NSAIDs) or aspirin are the main risk factors of both gastric and duodenal peptic ulcers. Evidence: TAS. Frequency: Very frequent (HP:0040281). (ORPHA:913)
- Esophagitis (HP:0100633): Inflammation of the esophagus. Evidence: TAS. Frequency: Very frequent (HP:0040281). (ORPHA:913)
- Weight loss (HP:0001824): Reduction of total body weight. Evidence: TAS. Frequency: Frequent (HP:0040282). (ORPHA:913)
- Hyperparathyroidism (HP:0000843): Excessive production of parathyroid hormone (PTH) by the parathyroid glands. Evidence: TAS. Frequency: Occasional (HP:0040283). (ORPHA:913)
- Elevated circulating growth hormone concentration (HP:0000845): Acromegaly is a condition resulting from overproduction of growth hormone by the pituitary gland in persons with closed epiphyses, and consists chiefly in the enlargement of the distal parts of the body. The circumference of the skull increases, the nose becomes broad, the tongue becomes enlarged, the facial features become coarsened, the mandible grows excessively, and the teeth become separated. The fingers and toes grow chiefly in thickness. Evidence: TAS. Frequency: Occasional (HP:0040283). (ORPHA:913)
- Thyroid adenoma (HP:0000854): The presence of a adenoma of the thyroid gland. Evidence: TAS. Frequency: Occasional (HP:0040283). (ORPHA:913)
- Jaundice (HP:0000952): Yellow pigmentation of the skin due to bilirubin, which in turn is the result of increased bilirubin concentration in the bloodstream. Evidence: TAS. Frequency: Occasional (HP:0040283). (ORPHA:913)
- Multiple lipomas (HP:0001012): The presence of multiple lipomas (a type of benign tissue made of fatty tissue). Evidence: TAS. Frequency: Occasional (HP:0040283). (ORPHA:913)
- Gastrointestinal hemorrhage (HP:0002239): Hemorrhage affecting the gastrointestinal tract. Evidence: TAS. Frequency: Occasional (HP:0040283). (ORPHA:913)
- Hematochezia (HP:0002573): The passage of fresh (red) blood per anus, usually in or with stools. Most rectal bleeding comes from the colon, rectum, or anus. Evidence: TAS. Frequency: Occasional (HP:0040283). (ORPHA:913)
- Pituitary adenoma (HP:0002893): A benign epithelial tumor derived from intrinsic cells of the adenohypophysis (anterior pituitary). Evidence: TAS. Frequency: Occasional (HP:0040283). (ORPHA:913)
- Hypercalcemia (HP:0003072): The concentration of calcium in the blood circulation is above the upper limit of normal. Evidence: TAS. Frequency: Occasional (HP:0040283). (ORPHA:913)
- Increased circulating cortisol level (HP:0003118): Overproduction of the hormone of cortisol by the adrenal cortex, resulting in a characteristic combination of clinical symptoms termed Cushing syndrome, with truncal obesity, a round, full face, striae atrophicae and acne, muscle weakness, and other features. Evidence: TAS. Frequency: Occasional (HP:0040283). (ORPHA:913)
- Elevated circulating parathyroid hormone level (HP:0003165): An abnormal increased concentration of parathyroid hormone. Evidence: TAS. Frequency: Occasional (HP:0040283). (ORPHA:913)
- Intestinal obstruction (HP:0005214): Blockage or impairment of the normal flow of the contents of the intestine towards the anal canal. Evidence: TAS. Frequency: Occasional (HP:0040283). (ORPHA:913)
- Pituitary prolactin cell adenoma (HP:0006767): A type of pituitary adenoma originating in prolactin secreting cells. This kind of adenoma is characterized by overproduction of prolactin, and may cause loss of menstrual periods and breast milk production in women. Evidence: TAS. Frequency: Occasional (HP:0040283). (ORPHA:913)
- Parathyroid hyperplasia (HP:0008208): Hyperplasia of the parathyroid gland. Evidence: TAS. Frequency: Occasional (HP:0040283). (ORPHA:913)
- Adrenocortical adenoma (HP:0008256): Adrenocortical adenomas are benign tumors of the adrenal cortex. Evidence: TAS. Frequency: Occasional (HP:0040283). (ORPHA:913)
- Pituitary corticotropic cell adenoma (HP:0008291): A type of pituitary adenoma that produces adrenocorticotropic hormone (ACTH). Evidence: TAS. Frequency: Occasional (HP:0040283). (ORPHA:913)
- Erythema (HP:0010783): Redness of the skin, caused by hyperemia of the capillaries in the lower layers of the skin. Evidence: TAS. Frequency: Occasional (HP:0040283). (ORPHA:913)
- Pituitary growth hormone cell adenoma (HP:0011760): A type of pituitary adenoma that produces growth hormone. Evidence: TAS. Frequency: Occasional (HP:0040283). (ORPHA:913)
- Pituitary null cell adenoma (HP:0011761): A type of pituitary adenoma that is of unknown cellular origin and that lacks immunocytochemical or fine structural markers. Null cell adenomas are not associated with hormone excess. Evidence: TAS. Frequency: Occasional (HP:0040283). (ORPHA:913)
- Increased urinary cortisol level (HP:0012030): Abnormally increased concentration of cortisol in the urine. Evidence: TAS. Frequency: Occasional (HP:0040283). (ORPHA:913)
- Lipoma (HP:0012032): Benign neoplasia derived from lipoblasts or lipocytes of white or brown fat. May be angiomatous or hibernomatous. Evidence: TAS. Frequency: Occasional (HP:0040283). (ORPHA:913)
- Extrahepatic cholestasis (HP:0012334): Impairment of bile flow due to obstruction in large bile ducts outside the liver. Evidence: TAS. Frequency: Occasional (HP:0040283). (ORPHA:913)
- Glucagonoma (HP:0030404): An endocrine tumor of the pancreas that secretes excessive amounts of glucagon. Evidence: TAS. Frequency: Occasional (HP:0040283). (ORPHA:913)
- Increased glucagon level (HP:0030688): An elevated concentration of glucagon in the blood circulation. Evidence: TAS. Frequency: Occasional (HP:0040283). (ORPHA:913)
- Adrenocortical carcinoma (HP:0006744): A malignant neoplasm of the adrenal cortex that may produce hormones such as cortisol, aldosterone, estrogen, or testosterone. Evidence: TAS. Frequency: Very rare (HP:0040284). (ORPHA:913)